Phenotypes associated with the disease congenital disorder of glycosylation, type i/IIx (OMIM:212067):
- Epileptic spasm (HP:0011097): A sudden flexion, extension, or mixed extension-flexion of predominantly proximal and truncal muscles that is usually more sustained than a myoclonic movement but not as sustained as a tonic seizure. Limited forms may occur: Grimacing, head nodding, or subtle eye movements. Epileptic spasms frequently occur in clusters. Infantile spasms are the best known form, but spasms can occur at all ages. Evidence: TAS. (OMIM:212067)
- Abnormal skin pigmentation (HP:0001000): An abnormality of the pigmentation of the skin. Evidence: IEA. (OMIM:212067)
- Seizure (HP:0001250): A seizure is an intermittent abnormality of nervous system physiology characterized by a transient occurrence of signs and/or symptoms due to abnormal excessive or synchronous neuronal activity in the brain. Evidence: IEA. (OMIM:212067)
- Abnormality of metabolism/homeostasis (HP:0001939). Evidence: IEA. (OMIM:212067)
- Autosomal recessive inheritance (HP:0000007): A mode of inheritance that is observed for traits related to a gene encoded on one of the autosomes (i.e., the human chromosomes 1-22) in which a trait manifests in individuals with two pathogenic alleles, either homozygotes (two copies of the same mutant allele) or compound heterozygotes (whereby each copy of a gene has a distinct mutant allele). Evidence: IEA. (OMIM:212067)
- Infantile spasms (HP:0012469): Infantile spasms represent a subset of "epileptic spasms". Infantile Spasms are epileptic spasms starting in the first year of life (infancy). Evidence: TAS. (OMIM:212067)